Phenotypes associated with the disease LSM7-related leukodystrophy and cerebellar atrophy (OMIM:621191):
- Strabismus (HP:0000486): A misalignment of the eyes so that the visual axes deviate from bifoveal fixation. The classification of strabismus may be based on a number of features including the relative position of the eyes, whether the deviation is latent or manifest, intermittent or constant, concomitant or otherwise and according to the age of onset and the relevance of any associated refractive error. Evidence: PCS. Frequency: 1/1. (PMID:39420558)
- Seizure (HP:0001250): A seizure is an intermittent abnormality of nervous system physiology characterized by a transient occurrence of signs and/or symptoms due to abnormal excessive or synchronous neuronal activity in the brain. Evidence: PCS. Frequency: 0/1. (PMID:39420558)
- Apraxia (HP:0002186): A defect in the understanding of complex motor commands and in the execution of certain learned movements, i.e., deficits in the cognitive components of learned movements. Evidence: PCS. Frequency: 1/1. (PMID:39420558)
- Sleep disturbance (HP:0002360): An abnormal pattern in the quality, quantity, or characteristics of sleep. Evidence: PCS. Frequency: 0/1. (PMID:39420558)
- Ataxia (HP:0001251): Ataxia refers to impaired coordination of voluntary muscle movement. Cerebellar ataxia refers to ataxia due to dysfunction of the cerebellum. This causes a variety of elementary neurological deficits including asynergy (lack of coordination between muscles, limbs and joints), dysmetria (lack of ability to judge distances that can lead to under- or overshoot in grasping movements), and dysdiadochokinesia (inability to perform rapid movements requiring antagonizing muscle groups to be switched on and off repeatedly). Evidence: PCS. Frequency: 1/1. (PMID:39420558)
- Encephalocele (HP:0002084): A neural tube defect characterized by sac-like protrusions of the brain and the membranes that cover it through openings in the skull. Evidence: PCS. Frequency: 1/1. (PMID:35047835)
- Oppositional defiant disorder (HP:0010865): An enduring pattern of uncooperative, defiant, and hostile behavior towards authority figures that does not involve major antisocial violations, is not accounted for by the child's developmental stage, and results in significant functional impairment. A certain level of oppositional behavior is common in children and adolescents. Evidence: PCS. Frequency: 1/1. (PMID:39420558)
- Nystagmus (HP:0000639): Rhythmic, involuntary oscillations of one or both eyes related to abnormality in fixation, conjugate gaze, or vestibular mechanisms. Evidence: PCS. Frequency: 1/1. (PMID:39420558)
- Anxiety (HP:0000739): Intense feelings of nervousness, tension, or panic often arise in response to interpersonal stresses. There is worry about the negative effects of past unpleasant experiences and future negative possibilities. Individuals may feel fearful, apprehensive, or threatened by uncertainty, and they may also have fears of falling apart or losing control. Evidence: PCS. Frequency: 1/1. (PMID:39420558)
- Leukodystrophy (HP:0002415): Leukodystrophy refers to deterioration of white matter of the brain resulting from degeneration of myelin sheaths in the CNS. Their basic defect is directly related to the synthesis and maintenance of myelin membranes. Symmetric white matter involvement at MRI is a typical finding in patients with leukodystrophies. Evidence: PCS. Frequency: 1/1. (PMID:35047835)
- Jaundice (HP:0000952): Yellow pigmentation of the skin due to bilirubin, which in turn is the result of increased bilirubin concentration in the bloodstream. Evidence: PCS. Frequency: 1/1. (PMID:39420558)
- Intellectual disability (HP:0001249): The term intellectual disability or intellectual developmental disorder is used to describe significantly sub-average intellectual and adaptive functioning based on clinical assessment and as measured by individually administered, appropriately normed, standardized and validated tests of intellectual functioning and adaptive behavior, with onset during the developmental period from infancy through adolescence. Evidence: PCS. Frequency: 1/1. (PMID:39420558)
- Premature birth (HP:0001622): The birth of a baby of less than 37 weeks of gestational age. Evidence: PCS. Frequency: 1/1. (PMID:39420558)
- Axial hypotonia (HP:0008936): Muscular hypotonia (abnormally low muscle tone) affecting the musculature of the trunk. Evidence: PCS. Frequency: 1/1. (PMID:39420558)
- Extrapyramidal dyskinesia (HP:0007308). Evidence: PCS. Frequency: 1/1. (PMID:39420558)
- Cerebellar hypoplasia (HP:0001321): Cerebellar hypoplasia is a descriptive term implying a cerebellum with a reduced volume, but a normal shape and is stable over time. Evidence: PCS. Frequency: 1/1. (PMID:35047835)
- Respiratory distress (HP:0002098): Respiratory distress is objectively observable as the physical or emotional consequences from the experience of dyspnea. The physical presentation of respiratory distress is generally referred to as labored breathing, while the sensation of respiratory distress is called shortness of breath or dyspnea. Evidence: PCS. Frequency: 1/1. (PMID:39420558)
- Feeding difficulties (HP:0011968): Impaired ability to eat related to problems gathering food and getting ready to suck, chew, or swallow it. Evidence: PCS. Frequency: 1/1. (PMID:35047835)
- Spastic tetraparesis (HP:0001285): Spastic weakness affecting all four limbs. Evidence: PCS. Frequency: 1/1. (PMID:39420558)
- Global developmental delay (HP:0001263): A delay in the achievement of motor or mental milestones in the domains of development of a child, including motor skills, speech and language, cognitive skills, and social and emotional skills. This term should only be used to describe children younger than five years of age. Evidence: PCS. Frequency: 2/2. (PMID:39420558;PMID:35047835)
- Tetraparesis (HP:0002273): Weakness of all four limbs. Evidence: PCS. Frequency: 1/1. (PMID:35047835)
- Postural instability (HP:0002172): A tendency to fall or the inability to keep oneself from falling; imbalance. The retropulsion test is widely regarded as the gold standard to evaluate postural instability, Use of the retropulsion test includes a rapid balance perturbation in the backward direction, and the number of balance correcting steps (or total absence thereof) is used to rate the degree of postural instability. Healthy subjects correct such perturbations with either one or two large steps, or without taking any steps, hinging rapidly at the hips while swinging the arms forward as a counterweight. In patients with balance impairment, balance correcting steps are often too small, forcing patients to take more than two steps. Taking three or more steps is generally considered to be abnormal, and taking more than five steps is regarded as being clearly abnormal. Markedly affected patients continue to step backward without ever regaining their balance and must be caught by the examiner (this would be called true retropulsion). Even more severely affected patients fail to correct entirely, and fall backward like a pushed toy soldier, without taking any corrective steps. Evidence: PCS. Frequency: 1/1. (PMID:39420558)
- Third trimester onset (HP:0034197): This term refers to a phenotypic feature that was first observed prior to birth during the third trimester, which is defined as 28 weeks and zero days (28+0) of gestation and beyond. Evidence: PCS. Frequency: 1/1. (PMID:35047835)
- Sensorineural hearing impairment (HP:0000407): A type of hearing impairment in one or both ears related to an abnormal functionality of the cochlear nerve. Evidence: PCS. Frequency: 1/2. (PMID:39420558;PMID:35047835)
- Increased nuchal translucency (HP:0010880): Nuchal translucency is the sonographic appearance of subcutaneous accumulation of liquid in the back of the fetal neck in the first trimester of pregnancy (11-14 gestational weeks of pregnancy). Evidence: PCS. Frequency: 1/1. (PMID:35047835)
- Autosomal recessive inheritance (HP:0000007): A mode of inheritance that is observed for traits related to a gene encoded on one of the autosomes (i.e., the human chromosomes 1-22) in which a trait manifests in individuals with two pathogenic alleles, either homozygotes (two copies of the same mutant allele) or compound heterozygotes (whereby each copy of a gene has a distinct mutant allele). Evidence: PCS. (PMID:35047835)
- Hypospadias (HP:0000047): Abnormal position of urethral meatus on the ventral penile shaft (underside) characterized by displacement of the urethral meatus from the tip of the glans penis to the ventral surface of the penis, scrotum, or perineum. Evidence: PCS. Frequency: 1/2. (PMID:39420558;PMID:35047835)
- Spasticity (HP:0001257): A motor disorder characterized by a velocity-dependent increase in tonic stretch reflexes with increased muscle tone, exaggerated (hyperexcitable) tendon reflexes. Evidence: PCS. Frequency: 1/1. (PMID:35047835)
- Tremor (HP:0001337): An unintentional, oscillating to-and-fro muscle movement about a joint axis. Evidence: PCS. Frequency: 1/1. (PMID:39420558)